- Reduced social responsiveness (HP:0012760): A reduced ability to participate in the back-and-forth flow of social interaction appropriate to culture and developmental level, which is normally characterized by an influence of the behavior of one person on the behavior of another person. This results in difficulty interacting with others through emotional, physical, or verbal communication. Evidence: TAS. Frequency: Occasional (HP:0040283). (ORPHA:96121)
- Posteriorly rotated ears (HP:0000358): A type of abnormal location of the ears in which the position of the ears is characterized by posterior rotation (the superior part of the ears is rotated towards the back of the head, and the inferior part of the ears towards the front). Evidence: TAS. Frequency: Frequent (HP:0040282). (ORPHA:96121)
- Aortic aneurysm (HP:0004942): Aortic dilatation refers to a dimension that is greater than the 95th percentile for the normal person age, sex and body size. In contrast, an aneurysm is defined as a localized dilation of the aorta that is more than 150 percent of predicted (ratio of observed to expected diameter 1.5 or more). Aneurysm should be distinguished from ectasia, which represents a diffuse dilation of the aorta less than 50 percent of normal aorta diameter. Evidence: TAS. Frequency: Frequent (HP:0040282). (ORPHA:96121)
- Delayed speech and language development (HP:0000750): A degree of language development that is significantly below the norm for a child of a specified age. Evidence: TAS. Frequency: Very frequent (HP:0040281). (ORPHA:96121)
- High palate (HP:0000218): Height of the palate more than 2 SD above the mean (objective) or palatal height at the level of the first permanent molar more than twice the height of the teeth (subjective). Evidence: TAS. Frequency: Frequent (HP:0040282). (ORPHA:96121)
- Thin upper lip vermilion (HP:0000219): Height of the vermilion of the upper lip in the midline more than 2 SD below the mean. Alternatively, an apparently reduced height of the vermilion of the upper lip in the frontal view (subjective). Evidence: TAS. Frequency: Frequent (HP:0040282). (ORPHA:96121)
- Brachycephaly (HP:0000248): An abnormality of skull shape characterized by a decreased anterior-posterior diameter. That is, a cephalic index greater than 81%. Alternatively, an apparently shortened anteroposterior dimension (length) of the head compared to width. Evidence: TAS. Frequency: Frequent (HP:0040282). (ORPHA:96121)
- Macrocephaly (HP:0000256): Occipitofrontal (head) circumference greater than 97th centile compared to appropriate, age matched, sex-matched normal standards. Alternatively, a apparently increased size of the cranium. Evidence: TAS. Frequency: Frequent (HP:0040282). (ORPHA:96121)
- Dolichocephaly (HP:0000268): An abnormality of skull shape characterized by a increased anterior-posterior diameter, i.e., an increased antero-posterior dimension of the skull. Cephalic index less than 76%. Alternatively, an apparently increased antero-posterior length of the head compared to width. Often due to premature closure of the sagittal suture. Evidence: TAS. Frequency: Frequent (HP:0040282). (ORPHA:96121)
- Retrognathia (HP:0000278): An abnormality in which the mandible is mislocalised posteriorly. Evidence: TAS. Frequency: Frequent (HP:0040282). (ORPHA:96121)
- Short philtrum (HP:0000322): Distance between nasal base and midline upper lip vermilion border more than 2 SD below the mean. Alternatively, an apparently decreased distance between nasal base and midline upper lip vermilion border. Evidence: TAS. Frequency: Frequent (HP:0040282). (ORPHA:96121)
- Broad forehead (HP:0000337): Width of the forehead or distance between the frontotemporales is more than two standard deviations above the mean (objective); or apparently increased distance between the two sides of the forehead. Evidence: TAS. Frequency: Frequent (HP:0040282). (ORPHA:96121)
- Micrognathia (HP:0000347): Developmental hypoplasia of the mandible. Evidence: TAS. Frequency: Frequent (HP:0040282). (ORPHA:96121)
- Abnormal earlobe morphology (HP:0000363): An abnormality of the lobule of pinna. Evidence: TAS. Frequency: Frequent (HP:0040282). (ORPHA:96121)
- Broad nasal tip (HP:0000455): Increase in width of the nasal tip. Evidence: TAS. Frequency: Frequent (HP:0040282). (ORPHA:96121)
- Deeply set eye (HP:0000490): An eye that is more deeply recessed into the plane of the face than is typical. Evidence: TAS. Frequency: Frequent (HP:0040282). (ORPHA:96121)
- Long eyelashes (HP:0000527): Mid upper eyelash length >10 mm or increased length of the eyelashes (subjective). Evidence: TAS. Frequency: Frequent (HP:0040282). (ORPHA:96121)
- Dental malocclusion (HP:0000689): Dental malocclusion refers to an abnormality of the occlusion, or alignment, of the teeth and the way the upper and lower teeth fit together, resulting in overcrowding of teeth or in abnormal bite patterns. Evidence: TAS. Frequency: Frequent (HP:0040282). (ORPHA:96121)
- Diastema (HP:0000699): Increased space between two adjacent teeth in the same dental arch. Evidence: TAS. Frequency: Frequent (HP:0040282). (ORPHA:96121)
- Anxiety (HP:0000739): Intense feelings of nervousness, tension, or panic often arise in response to interpersonal stresses. There is worry about the negative effects of past unpleasant experiences and future negative possibilities. Individuals may feel fearful, apprehensive, or threatened by uncertainty, and they may also have fears of falling apart or losing control. Evidence: TAS. Frequency: Frequent (HP:0040282). (ORPHA:96121)
- Hyperactivity (HP:0000752): Hyperactivity is a condition characterized by constant and unusually high levels of activity, even in situations where it is deemed inappropriate. Evidence: TAS. Frequency: Frequent (HP:0040282). (ORPHA:96121)
- Congenital diaphragmatic hernia (HP:0000776): The presence of a hernia of the diaphragm present at birth. Evidence: TAS. Frequency: Frequent (HP:0040282). (ORPHA:96121)
- Single transverse palmar crease (HP:0000954): The distal and proximal transverse palmar creases are merged into a single transverse palmar crease. Evidence: TAS. Frequency: Frequent (HP:0040282). (ORPHA:96121)
- Mild intellectual disability (HP:0001256): Mild intellectual disability (ID) is defined as a type of ID characterized by mildly sub-average adaptive functioning and intellectual functioning, with an intelligence quotient (IQ) the range of 50-69. Evidence: TAS. Frequency: Frequent (HP:0040282). (ORPHA:96121)
- Motor delay (HP:0001270): A type of Developmental delay characterized by a delay in acquiring motor skills. Evidence: TAS. Frequency: Frequent (HP:0040282). (ORPHA:96121)
- Generalized hypotonia (HP:0001290): Generalized muscular hypotonia (abnormally low muscle tone). Evidence: TAS. Frequency: Frequent (HP:0040282). (ORPHA:96121)
- Dysmetria (HP:0001310): A type of ataxia characterized by the inability to carry out movements with the correct range and motion across the plane of more than one joint related to incorrect estimation of the distances required for targeted movements. Evidence: TAS. Frequency: Frequent (HP:0040282). (ORPHA:96121)
- Cerebellar hypoplasia (HP:0001321): Cerebellar hypoplasia is a descriptive term implying a cerebellum with a reduced volume, but a normal shape and is stable over time. Evidence: TAS. Frequency: Frequent (HP:0040282). (ORPHA:96121)
- Craniosynostosis (HP:0001363): Craniosynostosis refers to the premature closure of the cranial sutures. Primary craniosynostosis refers to the closure of one or more sutures due to abnormalities in skull development, and secondary craniosynostosis results from failure of brain growth. Evidence: TAS. Frequency: Frequent (HP:0040282). (ORPHA:96121)
- Abnormal facial shape (HP:0001999): An abnormal morphology (form) of the face or its components. Evidence: TAS. Frequency: Frequent (HP:0040282). (ORPHA:96121)
- Morphological central nervous system abnormality (HP:0002011): A structural abnormality of the central nervous system. Evidence: TAS. Frequency: Frequent (HP:0040282). (ORPHA:96121)
- Ventriculomegaly (HP:0002119): An increase in size of the ventricular system of the brain. Evidence: TAS. Frequency: Frequent (HP:0040282). (ORPHA:96121)
- Unsteady gait (HP:0002317). Evidence: TAS. Frequency: Frequent (HP:0040282). (ORPHA:96121)
- Moderate intellectual disability (HP:0002342): Moderate intellectual disability (ID) is defined as a type of ID characterized by moderately sub-average adaptive functioning and intellectual functioning, with an intelligence quotient (IQ) the range of 35-49. Evidence: TAS. Frequency: Frequent (HP:0040282). (ORPHA:96121)
- Simplified gyral pattern (HP:0009879): An abnormality of the cerebral cortex with fewer gyri but with normal cortical thickness. This pattern is usually often associated with congenital microcephaly. Evidence: TAS. Frequency: Frequent (HP:0040282). (ORPHA:96121)
- Abnormal columella morphology (HP:0009929): A structural abnormality of the columella. Evidence: TAS. Frequency: Frequent (HP:0040282). (ORPHA:96121)
- Chronic constipation (HP:0012450): Constipation for longer than three months with fewer than 3 bowel movements per week, straining, lumpy or hard stools, and a sensation of anorectal obstruction or incomplete defecation. Evidence: TAS. Frequency: Frequent (HP:0040282). (ORPHA:96121)
- Inguinal hernia (HP:0000023): Protrusion of the contents of the abdominal cavity through the inguinal canal. Evidence: TAS. Frequency: Occasional (HP:0040283). (ORPHA:96121)
- Cryptorchidism (HP:0000028): Testis in inguinal canal. That is, absence of one or both testes from the scrotum owing to failure of the testis or testes to descend through the inguinal canal to the scrotum. Evidence: TAS. Frequency: Occasional (HP:0040283). (ORPHA:96121)
- Short lingual frenulum (HP:0000200): The presence of an abnormally short lingual frenulum. Evidence: TAS. Frequency: Occasional (HP:0040283). (ORPHA:96121)
- Thin vermilion border (HP:0000233): Height of the vermilion of the medial part of the lip more than 2 SD below the mean, or apparently reduced height of the vermilion of the lip in the frontal view. The vermilion is the red part of the lips (and confusingly, the vermilion itself is also often referred to as being equivalent the lips). Evidence: TAS. Frequency: Occasional (HP:0040283). (ORPHA:96121)
- Hypertelorism (HP:0000316): Interpupillary distance more than 2 SD above the mean (alternatively, the appearance of an increased interpupillary distance or widely spaced eyes). Evidence: TAS. Frequency: Occasional (HP:0040283). (ORPHA:96121)
- High forehead (HP:0000348): An abnormally increased height of the forehead. Evidence: TAS. Frequency: Occasional (HP:0040283). (ORPHA:96121)
- Chronic otitis media (HP:0000389): Chronic otitis media refers to fluid, swelling, or infection of the middle ear that does not heal and may cause permanent damage to the ear. Evidence: TAS. Frequency: Occasional (HP:0040283). (ORPHA:96121)
- Overfolded helix (HP:0000396): A condition in which the helix is folded over to a greater degree than normal. That is, excessive curling of the helix edge, whereby the free edge is parallel to the plane of the ear. Evidence: TAS. Frequency: Occasional (HP:0040283). (ORPHA:96121)
- Esotropia (HP:0000565): A form of strabismus with one or both eyes turned inward ('crossed') to a relatively severe degree, usually defined as 10 diopters or more. Evidence: TAS. Frequency: Occasional (HP:0040283). (ORPHA:96121)
- Aggressive behavior (HP:0000718): Behavior or an act aimed at harming a person, animal, or physical property (e.g., acts of physical violence; shouting, swearing, and using harsh language; slashing someone's tires). Evidence: TAS. Frequency: Occasional (HP:0040283). (ORPHA:96121)
- Motor stereotypy (HP:0000733): Use of the same abnormal action in response to certain triggers or at random. They may be used as a way to regulate one's internal state but must otherwise have no apparent functional purpose. Evidence: TAS. Frequency: Occasional (HP:0040283). (ORPHA:96121)
- Autism with high cognitive abilities (HP:0000753). Evidence: TAS. Frequency: Occasional (HP:0040283). (ORPHA:96121)
- Cutis marmorata (HP:0000965): A reticular discoloration of the skin with cyanotic (reddish-blue appearing) areas surrounding pale central areas due to dilation of capillary blood vessels and stagnation of blood within the vessels. Cutis marmorata generally occurs on the legs, arms and trunk and is often more severe in cold weather. Evidence: TAS. Frequency: Occasional (HP:0040283). (ORPHA:96121)
- Seizure (HP:0001250): A seizure is an intermittent abnormality of nervous system physiology characterized by a transient occurrence of signs and/or symptoms due to abnormal excessive or synchronous neuronal activity in the brain. Evidence: TAS. Frequency: Occasional (HP:0040283). (ORPHA:96121)
- Joint hypermobility (HP:0001382): The capability that a joint (or a group of joints) has to move, passively and/or actively, beyond normal limits along physiological axes. Evidence: TAS. Frequency: Occasional (HP:0040283). (ORPHA:96121)
- Growth delay (HP:0001510): A deficiency or slowing down of growth pre- and postnatally. Evidence: TAS. Frequency: Occasional (HP:0040283). (ORPHA:96121)
- Obesity (HP:0001513): Accumulation of substantial excess body fat. Evidence: TAS. Frequency: Occasional (HP:0040283). (ORPHA:96121)
- Patent ductus arteriosus (HP:0001643): In utero, the ductus arteriosus (DA) serves to divert ventricular output away from the lungs and toward the placenta by connecting the main pulmonary artery to the descending aorta. A patent ductus arteriosus (PDA) in the first 3 days of life is a physiologic shunt in healthy term and preterm newborn infants, and normally is substantially closed within about 24 hours after bith and completely closed after about three weeks. Failure of physiologcal closure is referred to a persistent or patent ductus arteriosus (PDA). Depending on the degree of left-to-right shunting, PDA can have clinical consequences. Evidence: TAS. Frequency: Occasional (HP:0040283). (ORPHA:96121)
- Mutism (HP:0002300): Complete lack of speech or verbal communication in a person despite attempts to engage in conversation. Mutism as a phenomena assumes the individual has previous capacity for speech and in the pediatric population it assumes that the person is past the age of typical language development. Evidence: TAS. Frequency: Occasional (HP:0040283). (ORPHA:96121)
- Drooling (HP:0002307): Habitual flow of saliva out of the mouth. Evidence: TAS. Frequency: Occasional (HP:0040283). (ORPHA:96121)
- Sleep disturbance (HP:0002360): An abnormal pattern in the quality, quantity, or characteristics of sleep. Evidence: TAS. Frequency: Occasional (HP:0040283). (ORPHA:96121)
- Polyphagia (HP:0002591): A neurological anomaly with gross overeating associated with an abnormally strong desire or need to eat. Evidence: TAS. Frequency: Occasional (HP:0040283). (ORPHA:96121)
- Short stature (HP:0004322): A height below that which is expected according to age and gender norms. Although there is no universally accepted definition of short stature, many refer to "short stature" as height more than 2 standard deviations below the mean for age and gender (or below the 3rd percentile for age and gender dependent norms). Evidence: TAS. Frequency: Occasional (HP:0040283). (ORPHA:96121)
- Sparse anterior scalp hair (HP:0004768): Decreased number of head hairs per unit area on the anterior region of the scalp. Evidence: TAS. Frequency: Occasional (HP:0040283). (ORPHA:96121)
- Large earlobe (HP:0009748): Increased volume of the earlobe, that is, abnormally prominent ear lobules. Evidence: TAS. Frequency: Occasional (HP:0040283). (ORPHA:96121)
- Impaired visuospatial constructive cognition (HP:0010794): Reduced ability affecting mainly visuospatial cognition which may be tested using pattern construction (for example by Differential Ability Scales, which test a person's strengths and weaknesses across a range of intellectual abilities). Evidence: TAS. Frequency: Occasional (HP:0040283). (ORPHA:96121)
- Severe intellectual disability (HP:0010864): Severe intellectual disability (ID) is defined as a type of ID characterized by severely sub-average adaptive functioning and intellectual functioning, with an intelligence quotient (IQ) the range of 20-34. Evidence: TAS. Frequency: Occasional (HP:0040283). (ORPHA:96121)
- Horizontal eyebrow (HP:0011228): An eyebrow that extends straight across the brow, without curve. Evidence: TAS. Frequency: Occasional (HP:0040283). (ORPHA:96121)
- Asymmetric crying face (HP:0011333): Asymmetry observed in the face of a neonate or infant whose face appears symmetric at rest and asymmetric during crying as the mouth is pulled downward on one side while not moving on the other side. Evidence: TAS. Frequency: Occasional (HP:0040283). (ORPHA:96121)
- Hypospadias (HP:0000047): Abnormal position of urethral meatus on the ventral penile shaft (underside) characterized by displacement of the urethral meatus from the tip of the glans penis to the ventral surface of the penis, scrotum, or perineum. Evidence: TAS. Frequency: Very rare (HP:0040284). (ORPHA:96121)
- Unilateral renal agenesis (HP:0000122): A unilateral form of agenesis of the kidney. Evidence: TAS. Frequency: Very rare (HP:0040284). (ORPHA:96121)
- Hydronephrosis (HP:0000126): Severe distention of the kidney with dilation of the renal pelvis and calices. Evidence: TAS. Frequency: Very rare (HP:0040284). (ORPHA:96121)
- Hydrocephalus (HP:0000238): Hydrocephalus is an active distension of the ventricular system of the brain resulting from inadequate passage of CSF from its point of production within the cerebral ventricles to its point of absorption into the systemic circulation. Evidence: TAS. Frequency: Very rare (HP:0040284). (ORPHA:96121)
- Round face (HP:0000311): The facial appearance is more circular than usual as viewed from the front. Evidence: TAS. Frequency: Very rare (HP:0040284). (ORPHA:96121)
- Hearing impairment (HP:0000365): A decreased magnitude of the sensory perception of sound. Evidence: TAS. Frequency: Very rare (HP:0040284). (ORPHA:96121)
- Short neck (HP:0000470): Diminished length of the neck. Evidence: TAS. Frequency: Very rare (HP:0040284). (ORPHA:96121)
- Astigmatism (HP:0000483): A type of refraction error associated with abnormal curvatures on the anterior and/or posterior surface of the cornea. Evidence: TAS. Frequency: Very rare (HP:0040284). (ORPHA:96121)
- Strabismus (HP:0000486): A misalignment of the eyes so that the visual axes deviate from bifoveal fixation. The classification of strabismus may be based on a number of features including the relative position of the eyes, whether the deviation is latent or manifest, intermittent or constant, concomitant or otherwise and according to the age of onset and the relevance of any associated refractive error. Evidence: TAS. Frequency: Very rare (HP:0040284). (ORPHA:96121)
- Exotropia (HP:0000577): A form of strabismus with one or both eyes deviated outward. Evidence: TAS. Frequency: Very rare (HP:0040284). (ORPHA:96121)
- Pectus excavatum (HP:0000767): A defect of the chest wall characterized by a depression of the sternum, giving the chest ("pectus") a caved-in ("excavatum") appearance. Evidence: TAS. Frequency: Very rare (HP:0040284). (ORPHA:96121)
- Enuresis (HP:0000805): Lack of the ability to control the urinary bladder leading to involuntary urination at an age where control of the bladder should already be possible. Evidence: TAS. Frequency: Very rare (HP:0040284). (ORPHA:96121)
- Cafe-au-lait spot (HP:0000957): Cafe-au-lait spots are hyperpigmented lesions that can vary in color from light brown to dark brown with smooth borders and having a size of 1.5 cm or more in adults and 0.5 cm or more in children. Evidence: TAS. Frequency: Very rare (HP:0040284). (ORPHA:96121)
- Sacral dimple (HP:0000960): A cutaneous indentation resulting from tethering of the skin to underlying structures (bone) of the intergluteal cleft. Evidence: TAS. Frequency: Very rare (HP:0040284). (ORPHA:96121)
- Ventricular septal defect (HP:0001629): A hole between the two bottom chambers (ventricles) of the heart. The defect is centered around the most superior aspect of the ventricular septum. Evidence: TAS. Frequency: Very rare (HP:0040284). (ORPHA:96121)
- Atrial septal defect (HP:0001631): Atrial septal defect (ASD) is a congenital abnormality of the interatrial septum that enables blood flow between the left and right atria via the interatrial septum. Evidence: TAS. Frequency: Very rare (HP:0040284). (ORPHA:96121)
- Aortic valve stenosis (HP:0001650): The presence of a stenosis (narrowing) of the aortic valve. Evidence: TAS. Frequency: Very rare (HP:0040284). (ORPHA:96121)
- Pes planus (HP:0001763): A foot where the longitudinal arch of the foot is in contact with the ground or floor when the individual is standing; or, in a patient lying supine, a foot where the arch is in contact with the surface of a flat board pressed against the sole of the foot by the examiner with a pressure similar to that expected from weight bearing; or, the height of the arch is reduced. Evidence: TAS. Frequency: Very rare (HP:0040284). (ORPHA:96121)
- Tracheomalacia (HP:0002779). Evidence: TAS. Frequency: Very rare (HP:0040284). (ORPHA:96121)
- Hemivertebrae (HP:0002937): Absence of one half of the vertebral body. Evidence: TAS. Frequency: Very rare (HP:0040284). (ORPHA:96121)
- Cubitus valgus (HP:0002967): Abnormal positioning in which the elbows are turned out. Evidence: TAS. Frequency: Very rare (HP:0040284). (ORPHA:96121)
- Impaired smooth pursuit (HP:0007772): An impairment of the ability to track objects with the ocular smooth pursuit system, a class of rather slow eye movements that minimizes retinal target motion. Evidence: TAS. Frequency: Very rare (HP:0040284). (ORPHA:96121)
- Aplasia/Hypoplasia of the fallopian tube (HP:0008655): Aplasia or developmental hypoplasia of the fallopian tube. Evidence: TAS. Frequency: Very rare (HP:0040284). (ORPHA:96121)
- Aplasia/hypoplasia of the uterus (HP:0008684): Absence or developmental hypoplasia of the uterus. Evidence: TAS. Frequency: Very rare (HP:0040284). (ORPHA:96121)
- Abnormal optic disc morphology (HP:0012795): A morphological abnormality of the optic disc, i.e., of the portion of the optic nerve clinically visible on fundoscopic examination. Evidence: TAS. Frequency: Very rare (HP:0040284). (ORPHA:96121)
- Collectionism (HP:0030212): Excessive or pathological tendency to save and collect possessions. Evidence: TAS. Frequency: Very rare (HP:0040284). (ORPHA:96121)
- Narrow palpebral fissure (HP:0045025): Reduction in the vertical distance between the upper and lower eyelids. Evidence: TAS. Frequency: Very rare (HP:0040284). (ORPHA:96121)
- Self-injurious behavior (HP:0100716): Self-aggression. Evidence: TAS. Frequency: Very rare (HP:0040284). (ORPHA:96121)
- Long fingers (HP:0100807): The middle finger is more than 2 SD above the mean for newborns 27 to 41 weeks EGA or above the 97th centile for children from birth to 16 years of age AND the five digits retain their normal length proportions relative to each other (i.e., it is not the case that the middle finger is the only lengthened digit), or, Fingers that appear disproportionately long compared to the palm of the hand. Evidence: TAS. Frequency: Very rare (HP:0040284). (ORPHA:96121)
These phenotypes are associated with the disease 7q11.23 microduplication syndrome (ORPHA:96121).